Phenotypes associated with the disease keratoconus posticus circumscriptus (OMIM:244600):
- Recurrent urinary tract infections (HP:0000010): Repeated infections of the urinary tract. Evidence: IEA. (OMIM:244600)
- Vesicoureteral reflux (HP:0000076): Abnormal (retrograde) movement of urine from the bladder into ureters or kidneys related to inadequacy of the valvular mechanism at the ureterovesicular junction or other causes. Evidence: IEA. (OMIM:244600)
- Cleft palate (HP:0000175): Cleft palate is a developmental defect of the palate resulting from a failure of fusion of the palatine processes and manifesting as a separation of the roof of the mouth (soft and hard palate). Evidence: TAS. (OMIM:244600)
- Limited elbow extension and supination (HP:0005852). Evidence: IEA. (OMIM:244600)
- Keratoconus (HP:0000563): A cone-shaped deformity of the cornea characterized by the presence of corneal distortion secondary to thinning of the apex. Evidence: IEA. (OMIM:244600)
- Brachydactyly (HP:0001156): Digits that appear disproportionately short compared to the hand/foot. The word brachydactyly is used here to describe a series distinct patterns of shortened digits (brachydactyly types A-E). This is the sense used here. Evidence: IEA. (OMIM:244600)
- Abnormal vertebral segmentation and fusion (HP:0005640). Evidence: IEA. (OMIM:244600)
- Global developmental delay (HP:0001263): A delay in the achievement of motor or mental milestones in the domains of development of a child, including motor skills, speech and language, cognitive skills, and social and emotional skills. This term should only be used to describe children younger than five years of age. Evidence: IEA. (OMIM:244600)
- Short neck (HP:0000470): Diminished length of the neck. Evidence: TAS. (OMIM:244600)
- Hypertelorism (HP:0000316): Interpupillary distance more than 2 SD above the mean (alternatively, the appearance of an increased interpupillary distance or widely spaced eyes). Evidence: IEA. (OMIM:244600)
- Autosomal recessive inheritance (HP:0000007): A mode of inheritance that is observed for traits related to a gene encoded on one of the autosomes (i.e., the human chromosomes 1-22) in which a trait manifests in individuals with two pathogenic alleles, either homozygotes (two copies of the same mutant allele) or compound heterozygotes (whereby each copy of a gene has a distinct mutant allele). Evidence: IEA. (OMIM:244600)
- Clinodactyly of the 5th finger (HP:0004209): Clinodactyly refers to a bending or curvature of the fifth finger in the radial direction (i.e., towards the 4th finger). Evidence: IEA. (OMIM:244600)
- Central posterior corneal opacity (HP:0008511): Reduced transparency of the central posterior portion of the corneal stroma. Evidence: IEA. (OMIM:244600)
- Webbed neck (HP:0000465): Pterygium colli is a congenital skin fold that runs along the sides of the neck down to the shoulders. It involves an ectopic fibrotic facial band superficial to the trapezius muscle. Excess hair-bearing skin is also present and extends down the cervical region well beyond the normal hairline. Evidence: IEA. (OMIM:244600)
- Growth delay (HP:0001510): A deficiency or slowing down of growth pre- and postnatally. Evidence: IEA. (OMIM:244600)
- Cleft upper lip (HP:0000204): A gap or groove in the upper lip. This is a congenital defect resulting from nonfusion of tissues of the lip during embryonal development. Evidence: TAS. (OMIM:244600)